Phenotypes associated with the disease hemolytic disease of fetus and newborn, RH-induced (OMIM:619462):
- Fetal pericardial effusion (HP:0025671): An abnormal accumulation of fluid in which the heart is partially or completely surrounded by fluid that is seen in all views and the thickness of the fluid as observed by prenatal ultrasound is above age-dependent norms. Evidence: TAS. (OMIM:619462)
- Polyhydramnios (HP:0001561): The presence of excess amniotic fluid in the uterus during pregnancy. Evidence: TAS. Onset: Antenatal onset (HP:0030674). (OMIM:619462)
- Kernicterus (HP:0001343): Damage to cerebral nuclei caused in infants by highly increased levels of unconjugated bilirubin. The basal ganglia and brainstem nuclei could be shown to have a yellow staining historically in infants who died of kernicterus, that is, kernicterus is strictly speaking a pathological diagnosis. The presence of kernicterus may be inferred in infants with characteristic acute or chronic bilirubin-induced neurological dysfunction. Evidence: TAS. (OMIM:619462)
- Fetal pleural effusion (HP:0025676): Fetal pleural effusion is the accumulation of excess fluid in the layers of tissue (pleura) lining the lungs and wall of the chest. It may be primary, also termed hydrothorax, occurring as an isolated finding or it may be secondary, most commonly resulting from non-immune hydrops. Evidence: TAS. (OMIM:619462)
- Fetal ascites (HP:0001791): Accumulation of fluid in the peritoneal cavity during the fetal period. Evidence: TAS. (OMIM:619462)
- Hepatomegaly (HP:0002240): Abnormally increased size of the liver. Evidence: TAS. (OMIM:619462)
- Hydrops fetalis (HP:0001789): The abnormal accumulation of fluid in two or more fetal compartments, including ascites, pleural effusion, pericardial effusion, and skin edema. Evidence: TAS. (OMIM:619462)
- Splenomegaly (HP:0001744): Abnormal increased size of the spleen. Evidence: TAS. (OMIM:619462)